- Abnormal cardiac septum morphology (HP:0001671): An anomaly of the intra-atrial or intraventricular septum. Evidence: TAS. (OMIM:614294)
- Congenital onset (HP:0003577): A phenotypic abnormality that is present at birth. Evidence: PCS. Frequency: 5/5. (PMID:20921022)
- Tented upper lip vermilion (HP:0010804): Triangular appearance of the oral aperture with the apex in the midpoint of the upper vermilion and the lower vermilion forming the base. Evidence: TAS. (OMIM:614294)
- Dextrocardia (HP:0001651): The heart is located in the right hand sided hemithorax. That is, there is a left-right reversal (or "mirror reflection") of the anatomical location of the heart in which the heart is locate on the right side instead of the left. Evidence: TAS. Frequency: Occasional (HP:0040283). (OMIM:614294)
- Inguinal hernia (HP:0000023): Protrusion of the contents of the abdominal cavity through the inguinal canal. Evidence: PCS. Frequency: 1/5. (PMID:20921022)
- Short stature (HP:0004322): A height below that which is expected according to age and gender norms. Although there is no universally accepted definition of short stature, many refer to "short stature" as height more than 2 standard deviations below the mean for age and gender (or below the 3rd percentile for age and gender dependent norms). Evidence: TAS. (OMIM:614294)
- Ventricular septal defect (HP:0001629): A hole between the two bottom chambers (ventricles) of the heart. The defect is centered around the most superior aspect of the ventricular septum. Evidence: PCS. Frequency: 1/5. (PMID:20921022)
- Hypertelorism (HP:0000316): Interpupillary distance more than 2 SD above the mean (alternatively, the appearance of an increased interpupillary distance or widely spaced eyes). Evidence: TAS. (OMIM:614294)
- Long fingers (HP:0100807): The middle finger is more than 2 SD above the mean for newborns 27 to 41 weeks EGA or above the 97th centile for children from birth to 16 years of age AND the five digits retain their normal length proportions relative to each other (i.e., it is not the case that the middle finger is the only lengthened digit), or, Fingers that appear disproportionately long compared to the palm of the hand. Evidence: TAS. (OMIM:614294)
- Polysplenia (HP:0001748): Polysplenia is a congenital disease manifested by multiple small accessory spleens. Evidence: PCS. Frequency: 1/5. (PMID:20921022)
- Hyperactivity (HP:0000752): Hyperactivity is a condition characterized by constant and unusually high levels of activity, even in situations where it is deemed inappropriate. Evidence: TAS. (OMIM:614294)
- Congenital diaphragmatic hernia (HP:0000776): The presence of a hernia of the diaphragm present at birth. Evidence: PCS. Frequency: 3/5. (PMID:20921022)
- Posteriorly rotated ears (HP:0000358): A type of abnormal location of the ears in which the position of the ears is characterized by posterior rotation (the superior part of the ears is rotated towards the back of the head, and the inferior part of the ears towards the front). Evidence: PCS. Frequency: 1/5. (PMID:20921022)
- Myopathic facies (HP:0002058): A facial appearance characteristic of myopathic conditions. The face appears expressionless with sunken cheeks, bilateral ptosis, and inability to elevate the corners of the mouth, due to muscle weakness. Evidence: TAS. (OMIM:614294)
- Flat occiput (HP:0005469): Reduced convexity of the occiput (posterior part of skull). Evidence: PCS. Frequency: 1/5. (PMID:20921022)
- Cleft palate (HP:0000175): Cleft palate is a developmental defect of the palate resulting from a failure of fusion of the palatine processes and manifesting as a separation of the roof of the mouth (soft and hard palate). Evidence: PCS. Frequency: 1/5. (PMID:20921022)
- Downslanted palpebral fissures (HP:0000494): The palpebral fissure inclination is more than two standard deviations below the mean. Evidence: TAS. (OMIM:614294)
- Thin vermilion border (HP:0000233): Height of the vermilion of the medial part of the lip more than 2 SD below the mean, or apparently reduced height of the vermilion of the lip in the frontal view. The vermilion is the red part of the lips (and confusingly, the vermilion itself is also often referred to as being equivalent the lips). Evidence: PCS. Frequency: 1/5. (PMID:20921022)
- Hypoplasia of the corpus callosum (HP:0002079): Underdevelopment of the corpus callosum. Evidence: PCS. Frequency: 1/3. (PMID:20921022)
- Global developmental delay (HP:0001263): A delay in the achievement of motor or mental milestones in the domains of development of a child, including motor skills, speech and language, cognitive skills, and social and emotional skills. This term should only be used to describe children younger than five years of age. Evidence: PCS. Frequency: 2/3. (PMID:20921022)
- Short neck (HP:0000470): Diminished length of the neck. Evidence: PCS. Frequency: 2/5. (PMID:20921022)
- Dilatation of renal calices (HP:0100581): An abnormal enlargement of the renal calices, the system of ducts of the kidney that collect urine. Evidence: PCS. Frequency: 1/5. (PMID:20921022)
- Coronary artery fistula (HP:0011641): A congenital malformation with abnormal connection between one of the coronary arteries and a heart chamber or another blood vessel. Evidence: PCS. Frequency: 1/5. (PMID:20921022)
- Pectus excavatum (HP:0000767): A defect of the chest wall characterized by a depression of the sternum, giving the chest ("pectus") a caved-in ("excavatum") appearance. Evidence: PCS. Frequency: 1/5. (PMID:20921022)
- Synophrys (HP:0000664): Meeting of the medial eyebrows in the midline. Evidence: PCS. Frequency: 1/5. (PMID:20921022)
- Intrauterine growth retardation (HP:0001511): An abnormal restriction of fetal growth with fetal weight below the tenth percentile for gestational age. Evidence: PCS. Frequency: 1/5. (PMID:20921022)
- Attention deficit hyperactivity disorder (HP:0007018): Attention deficit hyperactivity disorder (ADHD) manifests at age 2-3 years or by first grade at the latest. The main symptoms are distractibility, impulsivity, hyperactivity, and often trouble organizing tasks and projects, difficulty going to sleep, and social problems from being aggressive, loud, or impatient. Evidence: TAS. (OMIM:614294)
- Growth delay (HP:0001510): A deficiency or slowing down of growth pre- and postnatally. Evidence: TAS. (OMIM:614294)
- Macrocytic anemia (HP:0001972): A type of anemia characterized by increased size of erythrocytes with increased mean corpuscular volume (MCV) and increased mean corpuscular hemoglobin (MCH). Evidence: TAS. (OMIM:614294)
- Webbed neck (HP:0000465): Pterygium colli is a congenital skin fold that runs along the sides of the neck down to the shoulders. It involves an ectopic fibrotic facial band superficial to the trapezius muscle. Excess hair-bearing skin is also present and extends down the cervical region well beyond the normal hairline. Evidence: PCS. Frequency: 2/5. (PMID:20921022)
- Autosomal dominant inheritance (HP:0000006): A mode of inheritance that is observed for traits related to a gene encoded on one of the autosomes (i.e., the human chromosomes 1-22) in which a trait manifests in heterozygotes. In the context of medical genetics, an autosomal dominant disorder is caused when a single copy of the mutant allele is present. Males and females are affected equally, and can both transmit the disorder with a risk of 50% for each child of inheriting the mutant allele. Evidence: PCS. (PMID:20921022)
- Cleft upper lip (HP:0000204): A gap or groove in the upper lip. This is a congenital defect resulting from nonfusion of tissues of the lip during embryonal development. Evidence: TAS. (OMIM:614294)
- Cryptorchidism (HP:0000028): Testis in inguinal canal. That is, absence of one or both testes from the scrotum owing to failure of the testis or testes to descend through the inguinal canal to the scrotum. Evidence: PCS. Frequency: 2/3. (PMID:20921022)
- Low-set ears (HP:0000369): Upper insertion of the ear to the scalp below an imaginary horizontal line drawn between the inner canthi of the eye and extending posteriorly to the ear. Evidence: PCS. Frequency: 1/5. (PMID:20921022)
These phenotypes are associated with the disease chromosome 15q25 deletion syndrome (OMIM:614294).